Phenotypes associated with the disease autosomal dominant nonsyndromic hearing loss 4A (OMIM:600652):
- Progressive sensorineural hearing impairment (HP:0000408): A progressive form of sensorineural hearing impairment. Evidence: IEA. (OMIM:600652)
- Autosomal dominant inheritance (HP:0000006): A mode of inheritance that is observed for traits related to a gene encoded on one of the autosomes (i.e., the human chromosomes 1-22) in which a trait manifests in heterozygotes. In the context of medical genetics, an autosomal dominant disorder is caused when a single copy of the mutant allele is present. Males and females are affected equally, and can both transmit the disorder with a risk of 50% for each child of inheriting the mutant allele. Evidence: IEA. (OMIM:600652)